Phenotypes associated with the disease Crane-Heise syndrome (ORPHA:1512):
- Cleft palate (HP:0000175): Cleft palate is a developmental defect of the palate resulting from a failure of fusion of the palatine processes and manifesting as a separation of the roof of the mouth (soft and hard palate). Evidence: TAS. Frequency: Very frequent (HP:0040281). (ORPHA:1512)
- Hypertelorism (HP:0000316): Interpupillary distance more than 2 SD above the mean (alternatively, the appearance of an increased interpupillary distance or widely spaced eyes). Evidence: TAS. Frequency: Very frequent (HP:0040281). (ORPHA:1512)
- Micrognathia (HP:0000347): Developmental hypoplasia of the mandible. Evidence: TAS. Frequency: Very frequent (HP:0040281). (ORPHA:1512)
- Anteverted nares (HP:0000463): Anteriorly-facing nostrils viewed with the head in the Frankfurt horizontal and the eyes of the observer level with the eyes of the subject. This gives the appearance of an upturned nose (upturned nasal tip). Evidence: TAS. Frequency: Very frequent (HP:0040281). (ORPHA:1512)
- Hypoplastic scapulae (HP:0000882): Underdeveloped scapula. Evidence: TAS. Frequency: Very frequent (HP:0040281). (ORPHA:1512)
- Intrauterine growth retardation (HP:0001511): An abnormal restriction of fetal growth with fetal weight below the tenth percentile for gestational age. Evidence: TAS. Frequency: Very frequent (HP:0040281). (ORPHA:1512)
- Talipes equinovarus (HP:0001762): Talipes equinovarus (also called clubfoot) typically has four main components: inversion and adduction of the forefoot; inversion of the heel and hindfoot; equinus (limitation of extension) of the ankle and subtalar joint; and internal rotation of the leg. Evidence: TAS. Frequency: Very frequent (HP:0040281). (ORPHA:1512)
- Decreased skull ossification (HP:0004331): A reduction in the magnitude or amount of ossification of the skull. Evidence: TAS. Frequency: Very frequent (HP:0040281). (ORPHA:1512)
- Depressed nasal bridge (HP:0005280): Posterior positioning of the nasal root in relation to the overall facial profile for age. Evidence: TAS. Frequency: Very frequent (HP:0040281). (ORPHA:1512)
- Aplastic clavicle (HP:0006660): Absence of the clavicles as a developmental defect. Evidence: TAS. Frequency: Very frequent (HP:0040281). (ORPHA:1512)
- Cryptorchidism (HP:0000028): Testis in inguinal canal. That is, absence of one or both testes from the scrotum owing to failure of the testis or testes to descend through the inguinal canal to the scrotum. Evidence: TAS. Frequency: Frequent (HP:0040282). (ORPHA:1512)
- Joint stiffness (HP:0001387): Joint stiffness is a perceived sensation of tightness in a joint or joints when attempting to move them after a period of inactivity. Joint stiffness typically subsides over time. Evidence: TAS. Frequency: Frequent (HP:0040282). (ORPHA:1512)
- Toe syndactyly (HP:0001770): Webbing or fusion of the toes, involving soft parts only or including bone structure. Bony fusions are referred to as "bony" Syndactyly if the fusion occurs in a radio-ulnar axis. Fusions of bones of the toes in a proximo-distal axis are referred to as "Symphalangism". Evidence: TAS. Frequency: Frequent (HP:0040282). (ORPHA:1512)
- Finger syndactyly (HP:0006101): Webbing or fusion of the fingers, involving soft parts only or including bone structure. Bony fusions are referred to as "bony" Syndactyly if the fusion occurs in a radio-ulnar axis. Fusions of bones of the fingers in a proximo-distal axis are referred to as "Symphalangism". Evidence: TAS. Frequency: Frequent (HP:0040282). (ORPHA:1512)
- Short distal phalanx of finger (HP:0009882): Short distance from the end of the finger to the most distal interphalangeal crease or the distal interphalangeal joint flexion point. That is, hypoplasia of one or more of the distal phalanx of finger. Evidence: TAS. Frequency: Frequent (HP:0040282). (ORPHA:1512)
- Abnormally ossified vertebrae (HP:0100569): An abnormality of the formation and mineralization of one or more vertebrae. Evidence: TAS. Frequency: Frequent (HP:0040282). (ORPHA:1512)
- Ventriculomegaly (HP:0002119): An increase in size of the ventricular system of the brain. Evidence: TAS. Frequency: Occasional (HP:0040283). (ORPHA:1512)
- Aplasia/Hypoplasia of the corpus callosum (HP:0007370): Absence or underdevelopment of the corpus callosum. Evidence: TAS. Frequency: Occasional (HP:0040283). (ORPHA:1512)
- Hypoplasia of penis (HP:0008736). Evidence: TAS. Frequency: Occasional (HP:0040283). (ORPHA:1512)
- Posteriorly rotated ears (HP:0000358): A type of abnormal location of the ears in which the position of the ears is characterized by posterior rotation (the superior part of the ears is rotated towards the back of the head, and the inferior part of the ears towards the front). Evidence: TAS. Frequency: Very frequent (HP:0040281). (ORPHA:1512)